- Diarrhea (HP:0002014): Abnormally increased frequency (usually defined as three or more) loose or watery bowel movements a day. Evidence: IEA. (OMIM:606528)
- Vomiting (HP:0002013): Forceful ejection of the contents of the stomach through the mouth by means of a series of involuntary spasmic contractions. Evidence: IEA. (OMIM:606528)
- Generalized aminoaciduria (HP:0002909): An increased concentration of all types of amino acid in the urine. Evidence: IEA. (OMIM:606528)
- Failure to thrive (HP:0001508): Failure to thrive (FTT) refers to a child whose physical growth is substantially below the norm. Evidence: IEA. (OMIM:606528)
- Abnormal intestine morphology (HP:0002242): An abnormality of the intestine. The closely related term enteropathy is used to refer to any disease of the intestine. Evidence: IEA. (OMIM:606528)
- Autosomal recessive inheritance (HP:0000007): A mode of inheritance that is observed for traits related to a gene encoded on one of the autosomes (i.e., the human chromosomes 1-22) in which a trait manifests in individuals with two pathogenic alleles, either homozygotes (two copies of the same mutant allele) or compound heterozygotes (whereby each copy of a gene has a distinct mutant allele). Evidence: IEA. (OMIM:606528)
- Hypoglycemia (HP:0001943): A decreased concentration of glucose in the blood. Evidence: IEA. (OMIM:606528)
- Feeding difficulties in infancy (HP:0008872): Impaired feeding performance of an infant as manifested by difficulties such as weak and ineffective sucking, brief bursts of sucking, and falling asleep during sucking. There may be difficulties with chewing or maintaining attention. Evidence: IEA. (OMIM:606528)
- Renal tubular dysfunction (HP:0000124): Abnormal function of the renal tubule. The basic functional unit of the kidney, the nephron, consists of a renal corpuscle attached to a renal tubule, with roughly 0.8 to 1.5 nephrons per adult kidney. The functions of the renal tubule include reabsorption of water, electrolytes, glucose, and amino acids and secretion of substances such as uric acid. Evidence: IEA. (OMIM:606528)
- Hyperinsulinemia (HP:0000842): An increased concentration of insulin in the blood. Evidence: TAS. (OMIM:606528)
- Congenital sensorineural hearing impairment (HP:0008527): A type of hearing impairment caused by an abnormal functionality of the cochlear nerve with congenital onset. Evidence: IEA. (OMIM:606528)
These phenotypes are associated with the disease homozygous 11P15-p14 deletion syndrome (OMIM:606528).